- Congenital onset (HP:0003577): A phenotypic abnormality that is present at birth. Evidence: PCS. Frequency: 2/2. (PMID:29449721)
- Abnormal vestibular function (HP:0001751): An abnormality of the functioning of the vestibular apparatus. Evidence: PCS. Frequency: 1/2. (PMID:29449721)
- Sensorineural hearing impairment (HP:0000407): A type of hearing impairment in one or both ears related to an abnormal functionality of the cochlear nerve. Evidence: PCS. Frequency: 2/2. Onset: Congenital onset (HP:0003577). (PMID:29449721)
- Autosomal recessive inheritance (HP:0000007): A mode of inheritance that is observed for traits related to a gene encoded on one of the autosomes (i.e., the human chromosomes 1-22) in which a trait manifests in individuals with two pathogenic alleles, either homozygotes (two copies of the same mutant allele) or compound heterozygotes (whereby each copy of a gene has a distinct mutant allele). Evidence: PCS. (PMID:29449721)
These phenotypes are associated with the disease hearing loss, autosomal recessive 110 (OMIM:618094).